- Constriction of peripheral visual field (HP:0001133): An absolute or relative decrease in retinal sensitivity extending from edge (periphery) of the visual field in a concentric pattern. The visual field is the area that is perceived simultaneously by a fixating eye. Evidence: PCS. (PMID:14681825)
- Autosomal recessive inheritance (HP:0000007): A mode of inheritance that is observed for traits related to a gene encoded on one of the autosomes (i.e., the human chromosomes 1-22) in which a trait manifests in individuals with two pathogenic alleles, either homozygotes (two copies of the same mutant allele) or compound heterozygotes (whereby each copy of a gene has a distinct mutant allele). Evidence: PCS. (PMID:14681825)
- Visual impairment (HP:0000505): Visual impairment (or vision impairment) is vision loss (of a person) to such a degree as to qualify as an additional support need through a significant limitation of visual capability resulting from either disease, trauma, or congenital or degenerative conditions that cannot be corrected by conventional means, such as refractive correction, medication, or surgery. Evidence: PCS. (PMID:14681825)
- Optic disc pallor (HP:0000543): A pale yellow discoloration of the optic disc (the area of the optic nerve head in the retina). The optic disc normally has a pinkish hue with a central yellowish depression. Evidence: PCS. (PMID:14681825)
- Undetectable light- and dark-adapted electroretinogram (HP:0007688): Absence of the combined rod-and-cone response on electroretinogram. Evidence: PCS. (PMID:14681825)
- Rod-cone dystrophy (HP:0000510): An inherited retinal disease subtype in which the rod photoreceptors appear to be more severely affected than the cone photoreceptors. Typical presentation is with nyctalopia (due to rod dysfunction) followed by loss of mid-peripheral field of vision, which gradually extends and leaves many patients with a small central island of vision due to the preservation of macular cones. Evidence: TAS. (OMIM:608380)
- Attenuation of retinal blood vessels (HP:0007843): Narrowing of the retinal blood vessels, both arterioles and venules. Evidence: PCS. (PMID:14681825)
These phenotypes are associated with the disease retinitis pigmentosa 26 (OMIM:608380).